Phenotypes associated with the disease cataract 37 (OMIM:614422):
- Developmental cataract (HP:0000519): A cataract that occurs congenitally as the result of a developmental defect, in contrast to the majority of cataracts that occur in adulthood as the result of degenerative changes of the lens. Evidence: IEA. (OMIM:614422)
- Autosomal dominant inheritance (HP:0000006): A mode of inheritance that is observed for traits related to a gene encoded on one of the autosomes (i.e., the human chromosomes 1-22) in which a trait manifests in heterozygotes. In the context of medical genetics, an autosomal dominant disorder is caused when a single copy of the mutant allele is present. Males and females are affected equally, and can both transmit the disorder with a risk of 50% for each child of inheriting the mutant allele. Evidence: TAS. (OMIM:614422)